Phenotypes associated with the disease Dentin dysplasia (ORPHA:1653):
- Abnormal dental enamel morphology (HP:0000682): An abnormality of the dental enamel. Evidence: TAS. Frequency: Very frequent (HP:0040281). (ORPHA:1653)
- Abnormal dental morphology (HP:0006482): An abnormality of the morphology of the tooth. Evidence: TAS. Frequency: Very frequent (HP:0040281). (ORPHA:1653)
- Increased bone mineral density (HP:0011001): An abnormal increase of bone mineral density, that is, of the amount of matter per cubic centimeter of bones which is often referred to as osteosclerosis. Osteosclerosis can be detected on radiological examination as an increased whiteness (density) of affected bones. Evidence: TAS. Frequency: Very frequent (HP:0040281). (ORPHA:1653)
- Exostoses (HP:0100777): An exostosis is a benign growth the projects outward from the bone surface. It is capped by cartilage, and arises from a bone that develops from cartilage. Evidence: TAS. Frequency: Frequent (HP:0040282). (ORPHA:1653)